- Abnormality of the skeletal system (HP:0000924): An abnormality of the skeletal system. Evidence: IEA. (OMIM:127800)
- Overgrowth (HP:0001548): Excessive postnatal growth which may comprise increased weight, increased length, and/or increased head circumference. Evidence: IEA. (OMIM:127800)
These phenotypes are associated with the disease dysplasia epiphysealis hemimelica (OMIM:127800).